- Coiled sperm flagella (HP:0032560): Sperm cells whose flagella are twisted (coiled). Evidence: PCS. Frequency: 3/3. (PMID:28552195)
- Male infertility (HP:0003251). Evidence: PCS. Frequency: 3/3. (PMID:28552195)
- Young adult onset (HP:0011462): Onset of disease at the age of between 16 and 40 years. Evidence: PCS. Frequency: 3/3. (PMID:28552195)
- Autosomal recessive inheritance (HP:0000007): A mode of inheritance that is observed for traits related to a gene encoded on one of the autosomes (i.e., the human chromosomes 1-22) in which a trait manifests in individuals with two pathogenic alleles, either homozygotes (two copies of the same mutant allele) or compound heterozygotes (whereby each copy of a gene has a distinct mutant allele). Evidence: PCS. (PMID:28552195)
- Reduced sperm motility (HP:0012207): An abnormal reduction in the mobility of ejaculated sperm. Evidence: PCS. Frequency: 3/3. (PMID:28552195)
- Absent sperm flagella (HP:0032558): Sperm cells lacking flagella. Evidence: PCS. Frequency: 3/3. (PMID:28552195)
- Short sperm flagella (HP:0032559): Sperm cells with abnormally short flagella. Evidence: PCS. Frequency: 3/3. (PMID:28552195)
These phenotypes are associated with the disease spermatogenic failure 19 (OMIM:617592).